Phenotypes associated with the disease pituitary adenoma 5, multiple types (OMIM:617540):
- Pituitary adenoma (HP:0002893): A benign epithelial tumor derived from intrinsic cells of the adenohypophysis (anterior pituitary). Evidence: PCS. (PMID:28413019)
- Adult onset (HP:0003581): Onset of disease manifestations in adulthood, defined here as at the age of 16 years or later. Evidence: PCS. (PMID:28413019)
- Typified by incomplete penetrance (HP:0003829): Description of conditions in which not all individuals with a given genotype exhibit the disease. Penetrance is the proportion that develop disease given a lifespan of 80 years. Evidence: PCS. (PMID:28413019)
- Autosomal dominant inheritance (HP:0000006): A mode of inheritance that is observed for traits related to a gene encoded on one of the autosomes (i.e., the human chromosomes 1-22) in which a trait manifests in heterozygotes. In the context of medical genetics, an autosomal dominant disorder is caused when a single copy of the mutant allele is present. Males and females are affected equally, and can both transmit the disorder with a risk of 50% for each child of inheriting the mutant allele. Evidence: PCS. (PMID:28413019)